- Epicanthus (HP:0000286): A fold of skin starting above the medial aspect of the upper eyelid and arching downward to cover, pass in front of and lateral to the medial canthus. Evidence: PCS. Frequency: 1/2. (PMID:31230720)
- Antenatal onset (HP:0030674): Onset prior to birth. Evidence: PCS. Frequency: 1/2. (PMID:31230720)
- Seizure (HP:0001250): A seizure is an intermittent abnormality of nervous system physiology characterized by a transient occurrence of signs and/or symptoms due to abnormal excessive or synchronous neuronal activity in the brain. Evidence: PCS. Frequency: 1/2. (PMID:31230720)
- Difficulty climbing stairs (HP:0003551): Reduced ability to climb stairs. Evidence: PCS. Frequency: 1/1. (PMID:29498452)
- Scapular winging (HP:0003691): Abnormal protrusion of the scapula away from the surface of the back. Evidence: PCS. Frequency: 1/1. (PMID:29498452)
- Toe joint contracture (HP:0034675): Lack of full passive range of motion (restrictions in flexion, extension, or other movements) of a toe joint resulting from structural changes of non-bony tissues, such as muscles, tendons, ligaments, joint capsules and/or skin. Evidence: PCS. Frequency: 1/2. (PMID:31230720)
- Gowers sign (HP:0003391): A phenomenon whereby patients are not able to stand up without the use of the hands owing to weakness of the proximal muscles of the lower limbs. Evidence: PCS. Frequency: 1/1. (PMID:29498452)
- Weakness of facial musculature (HP:0030319): Reduced strength of one or more muscles innervated by the facial nerve (the seventh cranial nerve). Evidence: PCS. Frequency: 1/1. (PMID:29498452)
- Echogenic intracardiac focus (HP:0010942): A finding of a focus of increased echogenicity upon prenatal ultrasound examination of the fetus. The foci may be present in one or both ventricles. Echogenic intracardiac focus (EICF) is defined as a focus of echogenicity comparable to bone, in the region of the papillary muscle in either or both ventricles of the fetal heart. Evidence: PCS. Frequency: 1/2. (PMID:31230720)
- Short finger (HP:0009381): Abnormally short finger associated with developmental hypoplasia. Evidence: PCS. Frequency: 1/2. (PMID:31230720)
- Failure to thrive (HP:0001508): Failure to thrive (FTT) refers to a child whose physical growth is substantially below the norm. Evidence: PCS. Frequency: 1/2. (PMID:31230720)
- Ulnar deviation of the hand (HP:0009487): Divergence of the longitudinal axis of the hand at the wrist in a posterior (ulnar) direction (i.e., towards the little finger). Evidence: PCS. Frequency: 1/2. (PMID:31230720)
- Prominent forehead (HP:0011220): Forward prominence of the entire forehead, due to protrusion of the frontal bone. Evidence: PCS. Frequency: 1/2. (PMID:31230720)
- Difficulty running (HP:0009046): Reduced ability to run. Evidence: PCS. Frequency: 1/1. (PMID:29498452)
- Broad forehead (HP:0000337): Width of the forehead or distance between the frontotemporales is more than two standard deviations above the mean (objective); or apparently increased distance between the two sides of the forehead. Evidence: PCS. Frequency: 1/2. (PMID:31230720)
- High palate (HP:0000218): Height of the palate more than 2 SD above the mean (objective) or palatal height at the level of the first permanent molar more than twice the height of the teeth (subjective). Evidence: PCS. Frequency: 2/3. (PMID:29498452;PMID:31230720)
- Type 1 muscle fiber predominance (HP:0003803): An abnormal predominance of type I muscle fibers (in general, this feature can only be observed on muscle biopsy). Evidence: PCS. Frequency: 1/1. (PMID:29498452)
- Proximal muscle weakness (HP:0003701): A lack of strength of the proximal muscles. Evidence: PCS. Frequency: 1/1. (PMID:29498452)
- Frequent falls (HP:0002359). Evidence: PCS. Frequency: 1/2. (PMID:31230720)
- Narrow face (HP:0000275): Bizygomatic (upper face) and bigonial (lower face) width are both more than 2 standard deviations below the mean (objective); or, an apparent reduction in the width of the upper and lower face (subjective). Evidence: PCS. Frequency: 1/1. (PMID:29498452)
- Skeletal muscle atrophy (HP:0003202): The presence of skeletal muscular atrophy (which is also known as amyotrophy). Evidence: PCS. Frequency: 1/2. (PMID:31230720)
- Juvenile onset (HP:0003621): Onset of signs or symptoms of disease between the age of 5 and 15 years. Evidence: PCS. Frequency: 1/1. (PMID:29498452)
- Centrally nucleated skeletal muscle fibers (HP:0003687): An abnormality in which the nuclei of sarcomeres take on an abnormally central localization (or in which this feature is found in an increased proportion of muscle cells). Evidence: PCS. Frequency: 1/1. (PMID:29498452)
- Scoliosis (HP:0002650): The presence of an abnormal lateral curvature of the spine. Evidence: PCS. Frequency: 1/2. (PMID:31230720)
- Delayed speech and language development (HP:0000750): A degree of language development that is significantly below the norm for a child of a specified age. Evidence: PCS. Frequency: 1/2. (PMID:31230720)
- Talipes equinovarus (HP:0001762): Talipes equinovarus (also called clubfoot) typically has four main components: inversion and adduction of the forefoot; inversion of the heel and hindfoot; equinus (limitation of extension) of the ankle and subtalar joint; and internal rotation of the leg. Evidence: PCS. Frequency: 1/2. (PMID:31230720)
- Delayed ability to walk (HP:0031936): A failure to achieve the ability to walk at an appropriate developmental stage. Most children learn to walk in a series of stages, and learn to walk short distances independently between 12 and 15 months. Evidence: PCS. Frequency: 1/2. (PMID:31230720)
- Blue sclerae (HP:0000592): An abnormal bluish coloration of the sclera. Evidence: PCS. Frequency: 1/2. (PMID:31230720)
- Global developmental delay (HP:0001263): A delay in the achievement of motor or mental milestones in the domains of development of a child, including motor skills, speech and language, cognitive skills, and social and emotional skills. This term should only be used to describe children younger than five years of age. Evidence: PCS. Frequency: 1/2. (PMID:31230720)
- Depressed nasal bridge (HP:0005280): Posterior positioning of the nasal root in relation to the overall facial profile for age. Evidence: PCS. Frequency: 1/2. (PMID:31230720)
- Hip dislocation (HP:0002827): Displacement of the femur from its normal location in the hip joint. Evidence: PCS. Frequency: 1/2. (PMID:31230720)
- Congenital contracture (HP:0002803): One or more flexion contractures (a bent joint that cannot be straightened actively or passively) that are present at birth. Evidence: PCS. Frequency: 1/2. (PMID:31230720)
- Autosomal recessive inheritance (HP:0000007): A mode of inheritance that is observed for traits related to a gene encoded on one of the autosomes (i.e., the human chromosomes 1-22) in which a trait manifests in individuals with two pathogenic alleles, either homozygotes (two copies of the same mutant allele) or compound heterozygotes (whereby each copy of a gene has a distinct mutant allele). Evidence: PCS. (PMID:29498452)
- Micrognathia (HP:0000347): Developmental hypoplasia of the mandible. Evidence: PCS. Frequency: 1/1. (PMID:29498452)
- Nemaline bodies (HP:0003798): Nemaline rods are abnormal bodies that can occur in skeletal muscle fibers. The rods can be observed on histological analysis of muscle biopsy tissue or upon electron microscopy, where they appear either as extensions of sarcomeric Z-lines, in random array without obvious attachment to Z-lines (often in areas devoid of sarcomeres) or in large clusters localized at the sarcolemma or intermyofibrillar spaces. Evidence: PCS. Frequency: 1/1. (PMID:29498452)
- Elbow contracture (HP:0034391): A limitation in the passive range of motion of the elbow resulting from loss of elasticity in the periarticular tissues owing to structural changes of non-bony tissues, such as muscles, tendons, ligaments, joint capsules or skin. Evidence: PCS. Frequency: 1/2. (PMID:31230720)
- Increased variability in muscle fiber diameter (HP:0003557): An abnormally high degree of muscle fiber size variation. This phenotypic feature can be observed upon muscle biopsy. Evidence: PCS. Frequency: 1/1. (PMID:29498452)
- Chronic diarrhea (HP:0002028): The presence of chronic diarrhea, which is usually taken to mean diarrhea that has persisted for over 4 weeks. Evidence: PCS. Frequency: 1/2. (PMID:31230720)
These phenotypes are associated with the disease congenital myopathy 20 (OMIM:620310).